- Hyperthyroidism (HP:0000836): An abnormality of thyroid physiology characterized by excessive secretion of the thyroid hormones thyroxine (i.e., T4) and/or 3,3',5-triiodo-L-thyronine zwitterion (i.e., triiodothyronine or T3). Evidence: TAS. Frequency: Very frequent (HP:0040281). (ORPHA:91347)
- Goiter (HP:0000853): An enlargement of the thyroid gland. Evidence: TAS. Frequency: Very frequent (HP:0040281). (ORPHA:91347)
- Elevated circulating thyroid-stimulating hormone concentration (HP:0002925): Increased concentration of thyroid-stimulating hormone (TSH) in the blood circulation. Evidence: TAS. Frequency: Very frequent (HP:0040281). (ORPHA:91347)
- Abnormal pituitary gland morphology (HP:0012503): An anomaly of the pituitary gland. Evidence: TAS. Frequency: Very frequent (HP:0040281). (ORPHA:91347)
- Enlarged pituitary gland (HP:0012505): An abnormally increased size of the pituitary gland. Evidence: TAS. Frequency: Very frequent (HP:0040281). (ORPHA:91347)
- Male hypogonadism (HP:0000026): Decreased functionality of the male gonad, i.e., of the testis, with reduced spermatogenesis or testosterone synthesis. Evidence: TAS. Frequency: Frequent (HP:0040282). (ORPHA:91347)
- Hypogonadotropic hypogonadism (HP:0000044): Hypogonadotropic hypogonadism is characterized by reduced function of the gonads (testes in males or ovaries in females) and results from the absence of the gonadal stimulating pituitary hormones: follicle stimulating hormone (FSH) and luteinizing hormone (LH). Evidence: TAS. Frequency: Frequent (HP:0040282). (ORPHA:91347)
- Female hypogonadism (HP:0000134): Decreased functionality of the female gonads, i.e., of the ovary. Evidence: TAS. Frequency: Frequent (HP:0040282). (ORPHA:91347)
- Hypogonadism (HP:0000135): A decreased functionality of the gonad. Evidence: TAS. Frequency: Frequent (HP:0040282). (ORPHA:91347)
- Abnormality of the menstrual cycle (HP:0000140): An abnormality of the ovulation cycle. Evidence: TAS. Frequency: Frequent (HP:0040282). (ORPHA:91347)
- Progressive visual loss (HP:0000529): A reduction of previously attained ability to see. Evidence: TAS. Frequency: Frequent (HP:0040282). (ORPHA:91347)
- Gynecomastia (HP:0000771): Abnormal development of large mammary glands in males resulting in breast enlargement. Evidence: TAS. Frequency: Frequent (HP:0040282). (ORPHA:91347)
- Impotence (HP:0000802): Inability to develop or maintain an erection of the penis. Evidence: TAS. Frequency: Frequent (HP:0040282). (ORPHA:91347)
- Irregular menstruation (HP:0000858): Abnormally high variation in the amount of time between periods. Evidence: TAS. Frequency: Frequent (HP:0040282). (ORPHA:91347)
- Decreased fertility in females (HP:0000868). Evidence: TAS. Frequency: Frequent (HP:0040282). (ORPHA:91347)
- Osteopenia (HP:0000938): Osteopenia is a term to define bone density that is not normal but also not as low as osteoporosis. By definition from the World Health Organization osteopenia is defined by bone densitometry as a T score -1 to -2.5. Evidence: TAS. Frequency: Frequent (HP:0040282). (ORPHA:91347)
- Osteoporosis (HP:0000939): Osteoporosis is a systemic skeletal disease characterized by low bone density and microarchitectural deterioration of bone tissue with a consequent increase in bone fragility. According to the WHO criteria, osteoporosis is defined as a BMD that lies 2.5 standard deviations or more below the average value for young healthy adults (a T-score below -2.5 SD). Evidence: TAS. Frequency: Frequent (HP:0040282). (ORPHA:91347)
- Hyperhidrosis (HP:0000975): Abnormal excessive perspiration (sweating) despite the lack of appropriate stimuli like hot and humid weather. Evidence: TAS. Frequency: Frequent (HP:0040282). (ORPHA:91347)
- Pallor (HP:0000980): Abnormally pale skin. Evidence: TAS. Frequency: Frequent (HP:0040282). (ORPHA:91347)
- Tremor (HP:0001337): An unintentional, oscillating to-and-fro muscle movement about a joint axis. Evidence: TAS. Frequency: Frequent (HP:0040282). (ORPHA:91347)
- Weight loss (HP:0001824): Reduction of total body weight. Evidence: TAS. Frequency: Frequent (HP:0040282). (ORPHA:91347)
- Palpitations (HP:0001962): A sensation that the heart is pounding or racing, which is a non-specific sign but may be a manifestation of arrhythmia. Evidence: TAS. Frequency: Frequent (HP:0040282). (ORPHA:91347)
- Vomiting (HP:0002013): Forceful ejection of the contents of the stomach through the mouth by means of a series of involuntary spasmic contractions. Evidence: TAS. Frequency: Frequent (HP:0040282). (ORPHA:91347)
- Nausea and vomiting (HP:0002017): Nausea is a commonly encountered symptom that has been defined as an unpleasant painless subjective feeling that one will imminently vomit. Vomiting has been defined as the forceful expulsion of the contents of the stomach, duodenum, or jejunum through the oral cavity. While nausea and vomiting are often thought to exist on a temporal continuum, this is not always the case. There are situations when severe nausea may be present without emesis and less frequently, when emesis may be present without preceding nausea. Evidence: TAS. Frequency: Frequent (HP:0040282). (ORPHA:91347)
- Headache (HP:0002315): Cephalgia, or pain sensed in various parts of the head, not confined to the area of distribution of any nerve. Evidence: TAS. Frequency: Frequent (HP:0040282). (ORPHA:91347)
- Hypotension (HP:0002615): Low Blood Pressure, vascular hypotension. Evidence: TAS. Frequency: Frequent (HP:0040282). (ORPHA:91347)
- Decreased circulating ACTH concentration (HP:0002920): The concentration of corticotropin, also known as adrenocorticotropic hormone (ACTH), is below the lower limit of normal in the blood circulation. Evidence: TAS. Frequency: Frequent (HP:0040282). (ORPHA:91347)
- Easy fatigability (HP:0003388): Increased susceptibility to fatigue. Evidence: TAS. Frequency: Frequent (HP:0040282). (ORPHA:91347)
- Secondary growth hormone deficiency (HP:0008240). Evidence: TAS. Frequency: Frequent (HP:0040282). (ORPHA:91347)
- Abnormal hair quantity (HP:0011362): An abnormal amount of hair. Evidence: TAS. Frequency: Frequent (HP:0040282). (ORPHA:91347)
- Central adrenal insufficiency (HP:0011734): A form of adrenal insufficiency related to a lack of ACTH, which leads to a decrease in the production of cortisol by the adrenal glands. Aldosterone production is not usually affected. Evidence: TAS. Frequency: Frequent (HP:0040282). (ORPHA:91347)
- Adrenocorticotropin deficient adrenal insufficiency (HP:0011735): Adrenal insufficiency secondary to a defect in ACTH production. Evidence: TAS. Frequency: Frequent (HP:0040282). (ORPHA:91347)
- Adrenocorticotropic hormone deficiency (HP:0011748): A reduced ability to secrete adrenocorticotropic hormone (ACTH), a hormone that stimulates the adrenal cortex to secrete of glucocorticoids such as cortisol. Evidence: TAS. Frequency: Frequent (HP:0040282). (ORPHA:91347)
- Thyroid crisis (HP:0011782). Evidence: TAS. Frequency: Frequent (HP:0040282). (ORPHA:91347)
- Decreased fertility in males (HP:0012041). Evidence: TAS. Frequency: Frequent (HP:0040282). (ORPHA:91347)
- Fatigue (HP:0012378): A subjective feeling of tiredness characterized by a lack of energy and motivation. Evidence: TAS. Frequency: Frequent (HP:0040282). (ORPHA:91347)
- Decreased female libido (HP:0030018): Diminished sexual desire in female. Evidence: TAS. Frequency: Frequent (HP:0040282). (ORPHA:91347)
- Erectile dysfunction (HP:0100639): A multidimensional but common male sexual dysfunction that involves an alteration in any of the components of the erectile response, including organic, relational and psychological. Evidence: TAS. Frequency: Frequent (HP:0040282). (ORPHA:91347)
- Ptosis (HP:0000508): The upper eyelid margin is positioned 3 mm or more lower than usual and covers the superior portion of the iris (objective); or, the upper lid margin obscures at least part of the pupil (subjective). Evidence: TAS. Frequency: Occasional (HP:0040283). (ORPHA:91347)
- Blindness (HP:0000618): Blindness is the condition of lacking visual perception defined as a profound reduction in visual perception. On the 6m visual acuity scale, blindness is defined as less than 3/60. On the 20ft visual acuity scale, blindness is defined as less than 20/400. On the decimal visual acuity scale, blindness is defined as less than 0.05. Blindness is typically characterized by a visual field of no greater than 10 degrees in radius around central fixation. Evidence: TAS. Frequency: Occasional (HP:0040283). (ORPHA:91347)
- Diplopia (HP:0000651): Diplopia is a condition in which a single object is perceived as two images, it is also known as double vision. Evidence: TAS. Frequency: Occasional (HP:0040283). (ORPHA:91347)
- Infertility (HP:0000789). Evidence: TAS. Frequency: Occasional (HP:0040283). (ORPHA:91347)
- Hypertension (HP:0000822): The presence of chronic increased pressure in the systemic arterial system. Evidence: TAS. Frequency: Occasional (HP:0040283). (ORPHA:91347)
- Delayed puberty (HP:0000823): Passing the age when puberty normally occurs with no physical or hormonal signs of the onset of puberty. Evidence: TAS. Frequency: Occasional (HP:0040283). (ORPHA:91347)
- Increased circulating gonadotropin level (HP:0000837): Overproduction of gonadotropins (FSH, LH) by the anterior pituitary gland. Evidence: TAS. Frequency: Occasional (HP:0040283). (ORPHA:91347)
- Elevated circulating growth hormone concentration (HP:0000845): Acromegaly is a condition resulting from overproduction of growth hormone by the pituitary gland in persons with closed epiphyses, and consists chiefly in the enlargement of the distal parts of the body. The circumference of the skull increases, the nose becomes broad, the tongue becomes enlarged, the facial features become coarsened, the mandible grows excessively, and the teeth become separated. The fingers and toes grow chiefly in thickness. Evidence: TAS. Frequency: Occasional (HP:0040283). (ORPHA:91347)
- Increased circulating prolactin concentration (HP:0000870): The presence of abnormally increased levels of prolactin in the blood. Prolactin is a peptide hormone produced by the anterior pituitary gland that plays a role in breast development and lactation during pregnancy. Evidence: TAS. Frequency: Occasional (HP:0040283). (ORPHA:91347)
- Sudden loss of visual acuity (HP:0001117): Severe loss of visual acuity within hours or days. This is characteristic of Leber hereditary optic neuropathy. Evidence: TAS. Frequency: Occasional (HP:0040283). (ORPHA:91347)
- Seizure (HP:0001250): A seizure is an intermittent abnormality of nervous system physiology characterized by a transient occurrence of signs and/or symptoms due to abnormal excessive or synchronous neuronal activity in the brain. Evidence: TAS. Frequency: Occasional (HP:0040283). (ORPHA:91347)
- Congestive heart failure (HP:0001635): The presence of an abnormality of cardiac function that is responsible for the failure of the heart to pump blood at a rate that is commensurate with the needs of the tissues or a state in which abnormally elevated filling pressures are required for the heart to do so. Heart failure is frequently related to a defect in myocardial contraction. Evidence: TAS. Frequency: Occasional (HP:0040283). (ORPHA:91347)
- Pericardial effusion (HP:0001698): Accumulation of fluid within the pericardium. Evidence: TAS. Frequency: Occasional (HP:0040283). (ORPHA:91347)
- Vertigo (HP:0002321): An abnormal sensation of spinning while the body is actually stationary. Evidence: TAS. Frequency: Occasional (HP:0040283). (ORPHA:91347)
- Hypokalemia (HP:0002900): The concentration of potassium(1+) in the blood circulation is below the lower limit of normal. Evidence: TAS. Frequency: Occasional (HP:0040283). (ORPHA:91347)
- Ventricular arrhythmia (HP:0004308). Evidence: TAS. Frequency: Occasional (HP:0040283). (ORPHA:91347)
- Supraventricular arrhythmia (HP:0005115): A type of arrhythmia that originates above the ventricles, whereby the electrical impulse propagates down the normal His Purkinje system similar to normal sinus rhythm. Evidence: TAS. Frequency: Occasional (HP:0040283). (ORPHA:91347)
- Cranial nerve paralysis (HP:0006824). Evidence: TAS. Frequency: Occasional (HP:0040283). (ORPHA:91347)
- Abducens palsy (HP:0006897): Malfunction of the abducens nerve as manifested by impairment of the ability of the affected eye to be moved outward. Patients who develop abducens nerve palsy often present with binocular horizontal diplopia, which is a double vision when looking at objects side by side. There will be a notable weakness of the ipsilateral lateral rectus muscle leading to a deficit in of eye abduction on the affected side. Some patients may present with a constant head turning movement to maintain binocular fusion and to lessen the degree of diplopia. Evidence: TAS. Frequency: Occasional (HP:0040283). (ORPHA:91347)
- Fourth cranial nerve palsy (HP:0007011): Paralysis of the fourth cranial (trochlear) nerve manifested as weakness of the superior oblique muscle which causes vertical diplopia that is maximal when the affected eye is adducted and directed inferiorly. Evidence: TAS. Frequency: Occasional (HP:0040283). (ORPHA:91347)
- Internal ophthalmoplegia (HP:0007942): Paralysis of the iris and ciliary apparatus. Evidence: TAS. Frequency: Occasional (HP:0040283). (ORPHA:91347)
- Periodic hypokalemic paresis (HP:0008153): Episodes of muscle weakness associated with reduced levels of potassium in the blood. Evidence: TAS. Frequency: Occasional (HP:0040283). (ORPHA:91347)
- Euthyroid hyperthyroxinemia (HP:0008247): Increased levels of thyroxine without evidence of clinical thyroid disease. Evidence: TAS. Frequency: Occasional (HP:0040283). (ORPHA:91347)
- Oculomotor nerve palsy (HP:0012246): Reduced ability to control the movement of the eye associated with damage to the third cranial nerve (the oculomotor nerve). Evidence: TAS. Frequency: Occasional (HP:0040283). (ORPHA:91347)
- Hemianopia (HP:0012377): Partial or complete loss of vision in one half of the visual field of one or both eyes. Evidence: TAS. Frequency: Occasional (HP:0040283). (ORPHA:91347)
- Heteronymous hemianopia (HP:0030517). Evidence: TAS. Frequency: Occasional (HP:0040283). (ORPHA:91347)
- Bitemporal hemianopia (HP:0030521). Evidence: TAS. Frequency: Occasional (HP:0040283). (ORPHA:91347)
- Abnormal visual field test (HP:0030588): Abnormal result of a test designed to test an individual's central and peripheral vision by determining the ability of the individual to perceive objects at differing locations of the visual field. Evidence: TAS. Frequency: Occasional (HP:0040283). (ORPHA:91347)
These phenotypes are associated with the disease TSH-secreting pituitary adenoma (ORPHA:91347).